- Abnormal hair morphology (HP:0001595): An abnormality of the hair. Evidence: IEA. (OMIM:266350)
- Nystagmus (HP:0000639): Rhythmic, involuntary oscillations of one or both eyes related to abnormality in fixation, conjugate gaze, or vestibular mechanisms. Evidence: IEA. (OMIM:266350)
- Photophobia (HP:0000613): Excessive sensitivity to light with the sensation of discomfort or pain in the eyes due to exposure to bright light. Evidence: IEA. (OMIM:266350)
- Autosomal recessive inheritance (HP:0000007): A mode of inheritance that is observed for traits related to a gene encoded on one of the autosomes (i.e., the human chromosomes 1-22) in which a trait manifests in individuals with two pathogenic alleles, either homozygotes (two copies of the same mutant allele) or compound heterozygotes (whereby each copy of a gene has a distinct mutant allele). Evidence: IEA. (OMIM:266350)
These phenotypes are associated with the disease red skin pigment anomaly of new guinea (OMIM:266350).